- Hearing impairment (HP:0000365): A decreased magnitude of the sensory perception of sound. Evidence: TAS. (OMIM:607239)
- Autosomal recessive inheritance (HP:0000007): A mode of inheritance that is observed for traits related to a gene encoded on one of the autosomes (i.e., the human chromosomes 1-22) in which a trait manifests in individuals with two pathogenic alleles, either homozygotes (two copies of the same mutant allele) or compound heterozygotes (whereby each copy of a gene has a distinct mutant allele). Evidence: TAS. (OMIM:607239)
These phenotypes are associated with the disease autosomal recessive nonsyndromic hearing loss 33 (OMIM:607239).